Phenotypes associated with the disease ear antitragus, tag at base of (OMIM:128290):
- Abnormality of the ear (HP:0000598): An abnormality of the ear. Evidence: IEA. (OMIM:128290)
- Autosomal dominant inheritance (HP:0000006): A mode of inheritance that is observed for traits related to a gene encoded on one of the autosomes (i.e., the human chromosomes 1-22) in which a trait manifests in heterozygotes. In the context of medical genetics, an autosomal dominant disorder is caused when a single copy of the mutant allele is present. Males and females are affected equally, and can both transmit the disorder with a risk of 50% for each child of inheriting the mutant allele. Evidence: IEA. (OMIM:128290)